- Congenital onset (HP:0003577): A phenotypic abnormality that is present at birth. Evidence: PCS. (PMID:24387994)
- Hearing impairment (HP:0000365): A decreased magnitude of the sensory perception of sound. Evidence: PCS. Frequency: 11/11. (PMID:24387994)
- Autosomal recessive inheritance (HP:0000007): A mode of inheritance that is observed for traits related to a gene encoded on one of the autosomes (i.e., the human chromosomes 1-22) in which a trait manifests in individuals with two pathogenic alleles, either homozygotes (two copies of the same mutant allele) or compound heterozygotes (whereby each copy of a gene has a distinct mutant allele). Evidence: PCS. (PMID:24387994)
These phenotypes are associated with the disease autosomal recessive nonsyndromic hearing loss 86 (OMIM:614617).